Phenotypes associated with the disease X-linked lethal multiple pterygium syndrome (OMIM:312150):
- Epicanthus (HP:0000286): A fold of skin starting above the medial aspect of the upper eyelid and arching downward to cover, pass in front of and lateral to the medial canthus. Evidence: IEA. (OMIM:312150)
- Malignant hyperthermia (HP:0002047): Malignant hyperthermia is characterized by a rapid increase in temperature to 39-42 degrees C. Malignant hyperthermia may occur in response to either inhalational anesthetics such as halothane, to muscle relaxants such as succinylcholine, or to exercise. Evidence: IEA. (OMIM:312150)
- Pulmonary hypoplasia (HP:0002089). Evidence: IEA. (OMIM:312150)
- Flexion contracture (HP:0001371): A flexion contracture is a bent (flexed) joint that cannot be straightened actively or passively. It is thus a chronic loss of joint motion due to structural changes in muscle, tendons, ligaments, or skin that prevents normal movement of joints. Evidence: IEA. (OMIM:312150)
- Joint dislocation (HP:0001373): Displacement or malalignment of joints. Evidence: IEA. (OMIM:312150)
- Short finger (HP:0009381): Abnormally short finger associated with developmental hypoplasia. Evidence: TAS. (OMIM:312150)
- Hypertelorism (HP:0000316): Interpupillary distance more than 2 SD above the mean (alternatively, the appearance of an increased interpupillary distance or widely spaced eyes). Evidence: IEA. (OMIM:312150)
- Abnormal cervical curvature (HP:0005905): The presence of an abnormal curvature of the cervical vertebral column. Evidence: IEA. (OMIM:312150)
- Fetal akinesia sequence (HP:0001989): Decreased fetal activity associated with multiple joint contractures, facial anomalies and pulmonary hypoplasia. Ultrasound examination may reveal polyhydramnios, ankylosis, scalp edema, and decreased chest movements (reflecting pulmonary hypoplasia). Evidence: IEA. (OMIM:312150)
- Increased susceptibility to fractures (HP:0002659): An abnormally increased tendency to fractures of bones caused by an abnormal reduction in bone strength that is generally associated with an increased risk of fracture. Evidence: IEA. (OMIM:312150)
- Cystic hygroma (HP:0000476): A cystic lymphatic lesion of the neck. Evidence: IEA. (OMIM:312150)
- Hypoplastic ventricle (HP:0001961): A congenital defect characterized by underdevelopment of a ventricle of the heart. Evidence: IEA. (OMIM:312150)
- Depressed nasal ridge (HP:0000457): Lack of prominence of the nose resulting from a posteriorly-placed nasal ridge. Evidence: IEA. (OMIM:312150)
- Cleft palate (HP:0000175): Cleft palate is a developmental defect of the palate resulting from a failure of fusion of the palatine processes and manifesting as a separation of the roof of the mouth (soft and hard palate). Evidence: IEA. (OMIM:312150)
- Polyhydramnios (HP:0001561): The presence of excess amniotic fluid in the uterus during pregnancy. Evidence: IEA. (OMIM:312150)
- Multiple pterygia (HP:0001040). Evidence: IEA. (OMIM:312150)
- Edema (HP:0000969): An abnormal accumulation of fluid beneath the skin, or in one or more cavities of the body. Evidence: IEA. (OMIM:312150)
- Vertebral fusion (HP:0002948): A developmental defect leading to the union of two adjacent vertebrae. Evidence: IEA. (OMIM:312150)
- Abnormal facial shape (HP:0001999): An abnormal morphology (form) of the face or its components. Evidence: IEA. (OMIM:312150)
- X-linked inheritance (HP:0001417): A mode of inheritance that is observed for traits related to a gene encoded on the X chromosome. Evidence: TAS. (OMIM:312150)
- Intrauterine growth retardation (HP:0001511): An abnormal restriction of fetal growth with fetal weight below the tenth percentile for gestational age. Evidence: IEA. (OMIM:312150)
- Thin ribs (HP:0000883): Ribs with a reduced diameter. Evidence: IEA. (OMIM:312150)
- Cleft upper lip (HP:0000204): A gap or groove in the upper lip. This is a congenital defect resulting from nonfusion of tissues of the lip during embryonal development. Evidence: TAS. (OMIM:312150)
- Micrognathia (HP:0000347): Developmental hypoplasia of the mandible. Evidence: IEA. (OMIM:312150)
- Low-set ears (HP:0000369): Upper insertion of the ear to the scalp below an imaginary horizontal line drawn between the inner canthi of the eye and extending posteriorly to the ear. Evidence: IEA. (OMIM:312150)
- Amyoplasia (HP:0003634): Congenital lack of development of the muscles, which are then replaced by a mixture of dense fat and fibrous tissue. Evidence: IEA. (OMIM:312150)